- Joint hypermobility (HP:0001382): The capability that a joint (or a group of joints) has to move, passively and/or actively, beyond normal limits along physiological axes. Evidence: TAS. Frequency: Frequent (HP:0040282). (ORPHA:2479)
- Micrognathia (HP:0000347): Developmental hypoplasia of the mandible. Evidence: TAS. Frequency: Very frequent (HP:0040281). (ORPHA:2479)
- Megalocornea (HP:0000485): An enlargement of the cornea with normal clarity and function. Megalocornea is diagnosed with a horizontal corneal diameter of 12 mm or more at birth or 13 mm or more after two years of age. Evidence: TAS. Frequency: Very frequent (HP:0040281). (ORPHA:2479)
- Intellectual disability (HP:0001249): The term intellectual disability or intellectual developmental disorder is used to describe significantly sub-average intellectual and adaptive functioning based on clinical assessment and as measured by individually administered, appropriately normed, standardized and validated tests of intellectual functioning and adaptive behavior, with onset during the developmental period from infancy through adolescence. Evidence: TAS. Frequency: Very frequent (HP:0040281). (ORPHA:2479)
- Hypotonia (HP:0001252): Hypotonia is an abnormally low muscle tone (the amount of tension or resistance to movement in a muscle). Even when relaxed, muscles have a continuous and passive partial contraction which provides some resistance to passive stretching. Hypotonia thus manifests as diminished resistance to passive stretching. Hypotonia is not the same as muscle weakness, although the two conditions can co-exist. Evidence: TAS. Frequency: Very frequent (HP:0040281). (ORPHA:2479)
- Global developmental delay (HP:0001263): A delay in the achievement of motor or mental milestones in the domains of development of a child, including motor skills, speech and language, cognitive skills, and social and emotional skills. This term should only be used to describe children younger than five years of age. Evidence: TAS. Frequency: Very frequent (HP:0040281). (ORPHA:2479)
- Frontal bossing (HP:0002007): Bilateral bulging of the lateral frontal bone prominences with relative sparing of the midline. Evidence: TAS. Frequency: Very frequent (HP:0040281). (ORPHA:2479)
- Abnormal speech pattern (HP:0002167): An abnormality in the sound (volume) or cadence (rate) of speech. Evidence: TAS. Frequency: Very frequent (HP:0040281). (ORPHA:2479)
- Abnormality of immune system physiology (HP:0010978): A functional abnormality of the immune system. Evidence: TAS. Frequency: Very frequent (HP:0040281). (ORPHA:2479)
- Open mouth (HP:0000194): A facial appearance characterized by a permanently or nearly permanently opened mouth. Evidence: TAS. Frequency: Frequent (HP:0040282). (ORPHA:2479)
- High palate (HP:0000218): Height of the palate more than 2 SD above the mean (objective) or palatal height at the level of the first permanent molar more than twice the height of the teeth (subjective). Evidence: TAS. Frequency: Frequent (HP:0040282). (ORPHA:2479)
- Epicanthus (HP:0000286): A fold of skin starting above the medial aspect of the upper eyelid and arching downward to cover, pass in front of and lateral to the medial canthus. Evidence: TAS. Frequency: Frequent (HP:0040282). (ORPHA:2479)
- Hypertelorism (HP:0000316): Interpupillary distance more than 2 SD above the mean (alternatively, the appearance of an increased interpupillary distance or widely spaced eyes). Evidence: TAS. Frequency: Frequent (HP:0040282). (ORPHA:2479)
- Wide nasal bridge (HP:0000431): Increased breadth of the nasal bridge (and with it, the nasal root). Evidence: TAS. Frequency: Frequent (HP:0040282). (ORPHA:2479)
- Downslanted palpebral fissures (HP:0000494): The palpebral fissure inclination is more than two standard deviations below the mean. Evidence: TAS. Frequency: Frequent (HP:0040282). (ORPHA:2479)
- Myopia (HP:0000545): An abnormality of refraction characterized by the ability to see objects nearby clearly, while objects in the distance appear blurry. Evidence: TAS. Frequency: Frequent (HP:0040282). (ORPHA:2479)
- Abnormal anterior chamber morphology (HP:0000593): Abnormality of the anterior chamber, which is the space in the eye that is behind the cornea and in front of the iris. Evidence: TAS. Frequency: Frequent (HP:0040282). (ORPHA:2479)
- Motor stereotypy (HP:0000733): Use of the same abnormal action in response to certain triggers or at random. They may be used as a way to regulate one's internal state but must otherwise have no apparent functional purpose. Evidence: TAS. Frequency: Frequent (HP:0040282). (ORPHA:2479)
- Tapered finger (HP:0001182): The gradual reduction in girth of the finger from proximal to distal. Evidence: TAS. Frequency: Frequent (HP:0040282). (ORPHA:2479)
- Seizure (HP:0001250): A seizure is an intermittent abnormality of nervous system physiology characterized by a transient occurrence of signs and/or symptoms due to abnormal excessive or synchronous neuronal activity in the brain. Evidence: TAS. Frequency: Frequent (HP:0040282). (ORPHA:2479)
- Scoliosis (HP:0002650): The presence of an abnormal lateral curvature of the spine. Evidence: TAS. Frequency: Frequent (HP:0040282). (ORPHA:2479)
- Kyphosis (HP:0002808): Exaggerated anterior convexity of the thoracic vertebral column. Evidence: TAS. Frequency: Frequent (HP:0040282). (ORPHA:2479)
- Genu varum (HP:0002970): A positional abnormality marked by outward bowing of the legs in which the knees stay wide apart when a person stands with the feet and ankles together. Evidence: TAS. Frequency: Frequent (HP:0040282). (ORPHA:2479)
- Short stature (HP:0004322): A height below that which is expected according to age and gender norms. Although there is no universally accepted definition of short stature, many refer to "short stature" as height more than 2 standard deviations below the mean for age and gender (or below the 3rd percentile for age and gender dependent norms). Evidence: TAS. Frequency: Frequent (HP:0040282). (ORPHA:2479)
- Hypoplasia of the iris (HP:0007676): Congenital underdevelopment of the iris. Evidence: TAS. Frequency: Frequent (HP:0040282). (ORPHA:2479)
- Metatarsus valgus (HP:0010508): A condition in which the anterior part of the foot rotates outward away from the midline of the body and the heel remains straight. Evidence: TAS. Frequency: Frequent (HP:0040282). (ORPHA:2479)
- Iridodonesis (HP:0100693): Tremulousness of the iris on movement of the eye, occurring in subluxation of the lens. Evidence: TAS. Frequency: Frequent (HP:0040282). (ORPHA:2479)
- Everted lower lip vermilion (HP:0000232): An abnormal configuration of the lower lip such that it is turned outward i.e., everted, with the Inner aspect of the lower lip vermilion (normally opposing the teeth) being visible in a frontal view. Evidence: TAS. Frequency: Occasional (HP:0040283). (ORPHA:2479)
- Microcephaly (HP:0000252): Head circumference below 2 standard deviations below the mean for age and gender. Evidence: TAS. Frequency: Occasional (HP:0040283). (ORPHA:2479)
- Macrocephaly (HP:0000256): Occipitofrontal (head) circumference greater than 97th centile compared to appropriate, age matched, sex-matched normal standards. Alternatively, a apparently increased size of the cranium. Evidence: TAS. Frequency: Occasional (HP:0040283). (ORPHA:2479)
- Short philtrum (HP:0000322): Distance between nasal base and midline upper lip vermilion border more than 2 SD below the mean. Alternatively, an apparently decreased distance between nasal base and midline upper lip vermilion border. Evidence: TAS. Frequency: Occasional (HP:0040283). (ORPHA:2479)
- Sensorineural hearing impairment (HP:0000407): A type of hearing impairment in one or both ears related to an abnormal functionality of the cochlear nerve. Evidence: TAS. Frequency: Occasional (HP:0040283). (ORPHA:2479)
- Protruding ear (HP:0000411): Angle formed by the plane of the ear and the mastoid bone greater than the 97th centile for age (objective); or, outer edge of the helix more than 2 cm from the mastoid at the point of maximum distance (objective). Evidence: TAS. Frequency: Occasional (HP:0040283). (ORPHA:2479)
- Astigmatism (HP:0000483): A type of refraction error associated with abnormal curvatures on the anterior and/or posterior surface of the cornea. Evidence: TAS. Frequency: Occasional (HP:0040283). (ORPHA:2479)
- Nystagmus (HP:0000639): Rhythmic, involuntary oscillations of one or both eyes related to abnormality in fixation, conjugate gaze, or vestibular mechanisms. Evidence: TAS. Frequency: Occasional (HP:0040283). (ORPHA:2479)
- Hypothyroidism (HP:0000821): Deficiency of thyroid hormone. Evidence: TAS. Frequency: Occasional (HP:0040283). (ORPHA:2479)
- Osteopenia (HP:0000938): Osteopenia is a term to define bone density that is not normal but also not as low as osteoporosis. By definition from the World Health Organization osteopenia is defined by bone densitometry as a T score -1 to -2.5. Evidence: TAS. Frequency: Occasional (HP:0040283). (ORPHA:2479)
- Ataxia (HP:0001251): Ataxia refers to impaired coordination of voluntary muscle movement. Cerebellar ataxia refers to ataxia due to dysfunction of the cerebellum. This causes a variety of elementary neurological deficits including asynergy (lack of coordination between muscles, limbs and joints), dysmetria (lack of ability to judge distances that can lead to under- or overshoot in grasping movements), and dysdiadochokinesia (inability to perform rapid movements requiring antagonizing muscle groups to be switched on and off repeatedly). Evidence: TAS. Frequency: Occasional (HP:0040283). (ORPHA:2479)
- EEG abnormality (HP:0002353): Abnormality observed by electroencephalogram (EEG), which is used to record of the brain's spontaneous electrical activity from multiple electrodes placed on the scalp. Evidence: TAS. Frequency: Occasional (HP:0040283). (ORPHA:2479)
- Hypercholesterolemia (HP:0003124): An increased concentration of cholesterol in the blood. Evidence: TAS. Frequency: Occasional (HP:0040283). (ORPHA:2479)
- Underdeveloped supraorbital ridges (HP:0009891): Flatness of the supraorbital portion of the frontal bones. Evidence: TAS. Frequency: Occasional (HP:0040283). (ORPHA:2479)
These phenotypes are associated with the disease Megalocornea-intellectual disability syndrome (ORPHA:2479).